Phenotypes associated with the disease Brugada syndrome 4 (OMIM:611876):
- Shortened QT interval (HP:0012232): Decreased time between the start of the Q wave and the end of the T wave as measured by the electrocardiogram (EKG). Evidence: PCS. (PMID:17224476)
- Atrial fibrillation (HP:0005110): An atrial arrhythmia characterized by disorganized atrial activity without discrete P waves on the surface EKG, but instead by an undulating baseline or more sharply circumscribed atrial deflections of varying amplitude an frequency ranging from 350 to 600 per minute. Evidence: PCS. (PMID:17224476)
- Syncope (HP:0001279): A transient loss of consciousness (i.e., characterized by a rapid onset, a short duration, and a spontaneous and complete recovery) due to cerebral hypoperfusion. Evidence: PCS. (PMID:17224476)
- Autosomal dominant inheritance (HP:0000006): A mode of inheritance that is observed for traits related to a gene encoded on one of the autosomes (i.e., the human chromosomes 1-22) in which a trait manifests in heterozygotes. In the context of medical genetics, an autosomal dominant disorder is caused when a single copy of the mutant allele is present. Males and females are affected equally, and can both transmit the disorder with a risk of 50% for each child of inheriting the mutant allele. Evidence: PCS. (PMID:17224476)